Phenotypes associated with the disease THOC6-related developmental delay-microcephaly-facial dysmorphism syndrome (ORPHA:363444):
- Abnormality of the dentition (HP:0000164): Any abnormality of the teeth. Evidence: TAS. Frequency: Very frequent (HP:0040281). (ORPHA:363444)
- High forehead (HP:0000348): An abnormally increased height of the forehead. Evidence: TAS. Frequency: Very frequent (HP:0040281). (ORPHA:363444)
- Deeply set eye (HP:0000490): An eye that is more deeply recessed into the plane of the face than is typical. Evidence: TAS. Frequency: Very frequent (HP:0040281). (ORPHA:363444)
- Delayed speech and language development (HP:0000750): A degree of language development that is significantly below the norm for a child of a specified age. Evidence: TAS. Frequency: Very frequent (HP:0040281). (ORPHA:363444)
- Abnormal facial shape (HP:0001999): An abnormal morphology (form) of the face or its components. Evidence: TAS. Frequency: Very frequent (HP:0040281). (ORPHA:363444)
- Long nose (HP:0003189): Distance from nasion to subnasale more than two standard deviations above the mean, or alternatively, an apparently increased length from the nasal root to the nasal base. Evidence: TAS. Frequency: Very frequent (HP:0040281). (ORPHA:363444)
- Low hanging columella (HP:0009765): Columella extending inferior to the level of the nasal base, when viewed from the side. Evidence: TAS. Frequency: Very frequent (HP:0040281). (ORPHA:363444)
- Mild microcephaly (HP:0040196): Decreased occipito-frontal (head) circumference (OFC). For the microcephaly OFC must be between -3 SD and -2 SD compared to appropriate, age matched, normal standards (i.e. -3 SD <= OFC < -2 SD). Evidence: TAS. Frequency: Very frequent (HP:0040281). (ORPHA:363444)
- Recurrent urinary tract infections (HP:0000010): Repeated infections of the urinary tract. Evidence: TAS. Frequency: Frequent (HP:0040282). (ORPHA:363444)
- Abnormality of the genitourinary system (HP:0000119): The presence of any abnormality of the genitourinary system. Evidence: TAS. Frequency: Frequent (HP:0040282). (ORPHA:363444)
- Retrognathia (HP:0000278): An abnormality in which the mandible is mislocalised posteriorly. Evidence: TAS. Frequency: Frequent (HP:0040282). (ORPHA:363444)
- Epicanthus (HP:0000286): A fold of skin starting above the medial aspect of the upper eyelid and arching downward to cover, pass in front of and lateral to the medial canthus. Evidence: TAS. Frequency: Frequent (HP:0040282). (ORPHA:363444)
- Smooth philtrum (HP:0000319): Flat skin surface, with no ridge formation in the central region of the upper lip between the nasal base and upper vermilion border. Evidence: TAS. Frequency: Frequent (HP:0040282). (ORPHA:363444)
- Carious teeth (HP:0000670): Caries is a multifactorial bacterial infection affecting the structure of the tooth. This term has been used to describe the presence of more than expected dental caries. Evidence: TAS. Frequency: Frequent (HP:0040282). (ORPHA:363444)
- Global developmental delay (HP:0001263): A delay in the achievement of motor or mental milestones in the domains of development of a child, including motor skills, speech and language, cognitive skills, and social and emotional skills. This term should only be used to describe children younger than five years of age. Evidence: TAS. Frequency: Frequent (HP:0040282). (ORPHA:363444)
- Abnormal heart morphology (HP:0001627): Any structural anomaly of the heart. Evidence: TAS. Frequency: Frequent (HP:0040282). (ORPHA:363444)
- Ventriculomegaly (HP:0002119): An increase in size of the ventricular system of the brain. Evidence: TAS. Frequency: Frequent (HP:0040282). (ORPHA:363444)
- Dysplastic corpus callosum (HP:0006989): Dysplasia and dysgenesis of the corpus callosum are nonspecific descriptions that imply defective development of the corpus callosum. The term dysplasia is applied when the morphology of the corpus callosum is altered as a congenital trait. For instance, the corpus callosum may be hump-shaped, kinked, or a striped corpus callosum that lacks an anatomically distinct genu and splenium. Evidence: TAS. Frequency: Frequent (HP:0040282). (ORPHA:363444)
- Severe intellectual disability (HP:0010864): Severe intellectual disability (ID) is defined as a type of ID characterized by severely sub-average adaptive functioning and intellectual functioning, with an intelligence quotient (IQ) the range of 20-34. Evidence: TAS. Frequency: Frequent (HP:0040282). (ORPHA:363444)
- Abnormal brain morphology (HP:0012443): A structural abnormality of the brain, which has as its parts the forebrain, midbrain, and hindbrain. Evidence: TAS. Frequency: Frequent (HP:0040282). (ORPHA:363444)
- Hypospadias (HP:0000047): Abnormal position of urethral meatus on the ventral penile shaft (underside) characterized by displacement of the urethral meatus from the tip of the glans penis to the ventral surface of the penis, scrotum, or perineum. Evidence: TAS. Frequency: Occasional (HP:0040283). (ORPHA:363444)
- Micropenis (HP:0000054): Abnormally small penis. At birth, the normal penis is about 3 cm (stretched length from pubic tubercle to tip of penis) with micropenis less than 2.0-2.5 cm. Evidence: TAS. Frequency: Occasional (HP:0040283). (ORPHA:363444)
- Abnormality of the kidney (HP:0000077): An abnormality of the kidney. Evidence: TAS. Frequency: Occasional (HP:0040283). (ORPHA:363444)
- Horseshoe kidney (HP:0000085): A connection of the right and left kidney by an isthmus of functioning renal parenchyma or fibrous tissue that crosses the midline. Evidence: TAS. Frequency: Occasional (HP:0040283). (ORPHA:363444)
- Unilateral renal agenesis (HP:0000122): A unilateral form of agenesis of the kidney. Evidence: TAS. Frequency: Occasional (HP:0040283). (ORPHA:363444)
- Thick upper lip vermilion (HP:0000215): Height of the vermilion of the upper lip in the midline more than 2 SD above the mean. Alternatively, an apparently increased height of the vermilion of the upper lip in the frontal view (subjective). Evidence: TAS. Frequency: Occasional (HP:0040283). (ORPHA:363444)
- Velopharyngeal insufficiency (HP:0000220): Inability of velopharyngeal sphincter to sufficiently separate the nasal cavity from the oral cavity during speech. Evidence: TAS. Frequency: Occasional (HP:0040283). (ORPHA:363444)
- Pointed chin (HP:0000307): A marked tapering of the lower face to the chin. Evidence: TAS. Frequency: Occasional (HP:0040283). (ORPHA:363444)
- Broad forehead (HP:0000337): Width of the forehead or distance between the frontotemporales is more than two standard deviations above the mean (objective); or apparently increased distance between the two sides of the forehead. Evidence: TAS. Frequency: Occasional (HP:0040283). (ORPHA:363444)
- Hearing impairment (HP:0000365): A decreased magnitude of the sensory perception of sound. Evidence: TAS. Frequency: Occasional (HP:0040283). (ORPHA:363444)
- Dental malocclusion (HP:0000689): Dental malocclusion refers to an abnormality of the occlusion, or alignment, of the teeth and the way the upper and lower teeth fit together, resulting in overcrowding of teeth or in abnormal bite patterns. Evidence: TAS. Frequency: Occasional (HP:0040283). (ORPHA:363444)
- Specific learning disability (HP:0001328): Impairment of certain skills such as reading or writing, coordination, self-control, or attention that interfere with the ability to learn. The impairment is not related to a global deficiency of intelligence. Evidence: TAS. Frequency: Occasional (HP:0040283). (ORPHA:363444)
- Atrial septal defect (HP:0001631): Atrial septal defect (ASD) is a congenital abnormality of the interatrial septum that enables blood flow between the left and right atria via the interatrial septum. Evidence: TAS. Frequency: Occasional (HP:0040283). (ORPHA:363444)
- Patent ductus arteriosus (HP:0001643): In utero, the ductus arteriosus (DA) serves to divert ventricular output away from the lungs and toward the placenta by connecting the main pulmonary artery to the descending aorta. A patent ductus arteriosus (PDA) in the first 3 days of life is a physiologic shunt in healthy term and preterm newborn infants, and normally is substantially closed within about 24 hours after bith and completely closed after about three weeks. Failure of physiologcal closure is referred to a persistent or patent ductus arteriosus (PDA). Depending on the degree of left-to-right shunting, PDA can have clinical consequences. Evidence: TAS. Frequency: Occasional (HP:0040283). (ORPHA:363444)
- Overlapping toe (HP:0001845): Describes a foot digit resting on the dorsal surface of an adjacent digit when the foot is at rest. Initially clawing may be dynamic and only noticeable on walking. Over time the plantar plate tears, subluxation occurs at the metatarsophalangeal joint (MTPJ), and the deformity becomes permanent. Evidence: TAS. Frequency: Occasional (HP:0040283). (ORPHA:363444)
- Anal atresia (HP:0002023): Congenital absence of the anus, i.e., the opening at the bottom end of the intestinal tract. Evidence: TAS. Frequency: Occasional (HP:0040283). (ORPHA:363444)
- Premature ovarian insufficiency (HP:0008209): Amenorrhea due to loss of ovarian function before the age of 40. Primary ovarian insuficiency (POI) is a state of female hypergonadotropic hypogonadism. It can manifest as primary amenorrhea with onset before menarche or secondary amenorrhea. Evidence: TAS. Frequency: Occasional (HP:0040283). (ORPHA:363444)
- High anterior hairline (HP:0009890): Distance between the hairline (trichion) and the glabella (the most prominent point on the frontal bone above the root of the nose), in the midline, more than two SD above the mean. Alternatively, an apparently increased distance between the hairline and the glabella. Evidence: TAS. Frequency: Occasional (HP:0040283). (ORPHA:363444)
- Thin lower lip vermilion (HP:0010282): Height of the vermilion of the medial part of the lower lip more than 2 SD below the mean. Alternatively, an apparently reduced height of the vermilion of the lower lip in the frontal view (subjective). Evidence: TAS. Frequency: Occasional (HP:0040283). (ORPHA:363444)
- Muscular ventricular septal defect (HP:0011623): The trabecular septum is the largest part of the interventricular septum. It extends from the membranous septum to the apex and superiorly to the infundibular septum. A defect in the trabecular septum is called muscular VSD if the defect is completely rimmed by muscle. Evidence: TAS. Frequency: Occasional (HP:0040283). (ORPHA:363444)
- Perimembranous ventricular septal defect (HP:0011682): A ventricular septal defect that is confluent with and involves the membranous septum and is bordered by an atrioventricular valve, not including the type 3 VSDs. Evidence: TAS. Frequency: Occasional (HP:0040283). (ORPHA:363444)
- Left-to-right shunt (HP:0012382): Pattern of blood flow in the heart that deviates from the normal circuit of the circulatory system from the left side of the heart to the right. Evidence: TAS. Frequency: Occasional (HP:0040283). (ORPHA:363444)
- Camptodactyly (HP:0012385): The distal interphalangeal joint and/or the proximal interphalangeal joint of the fingers or toes cannot be extended to 180 degrees by either active or passive extension. Evidence: TAS. Frequency: Occasional (HP:0040283). (ORPHA:363444)
- Endometriosis (HP:0030127): The growth of endometrial tissue outside the uterus. Evidence: TAS. Frequency: Occasional (HP:0040283). (ORPHA:363444)